Phenotypes associated with the disease intellectual disability, autosomal recessive 64 (OMIM:618103):
- Hypertonia (HP:0001276): A condition in which there is increased muscle tone so that arms or legs, for example, are stiff and difficult to move. Evidence: PCS. Frequency: 2/5. (PMID:28837161)
- Microcephaly (HP:0000252): Head circumference below 2 standard deviations below the mean for age and gender. Evidence: PCS. Frequency: 4/5. (PMID:28837161)
- Absent speech (HP:0001344): Complete lack of development of speech and language abilities. Evidence: PCS. Frequency: 3/5. (PMID:28837161)
- Feeding difficulties (HP:0011968): Impaired ability to eat related to problems gathering food and getting ready to suck, chew, or swallow it. Evidence: PCS. Frequency: 2/5. (PMID:28837161)
- Seizure (HP:0001250): A seizure is an intermittent abnormality of nervous system physiology characterized by a transient occurrence of signs and/or symptoms due to abnormal excessive or synchronous neuronal activity in the brain. Evidence: PCS. Frequency: 1/5. (PMID:28837161)
- Global developmental delay (HP:0001263): A delay in the achievement of motor or mental milestones in the domains of development of a child, including motor skills, speech and language, cognitive skills, and social and emotional skills. This term should only be used to describe children younger than five years of age. Evidence: PCS. Frequency: 5/5. (PMID:28837161)
- Slurred speech (HP:0001350): Abnormal coordination of muscles involved in speech. Evidence: PCS. Frequency: 2/5. (PMID:28837161)
- Infantile onset (HP:0003593): Onset of signs or symptoms of disease between 28 days to one year of life. Evidence: PCS. Frequency: 5/5. (PMID:28837161)
- Motor delay (HP:0001270): A type of Developmental delay characterized by a delay in acquiring motor skills. Evidence: PCS. Frequency: 5/5. (PMID:28837161)
- Severe intellectual disability (HP:0010864): Severe intellectual disability (ID) is defined as a type of ID characterized by severely sub-average adaptive functioning and intellectual functioning, with an intelligence quotient (IQ) the range of 20-34. Evidence: PCS. Frequency: 5/5. (PMID:28837161)
- Reduced social responsiveness (HP:0012760): A reduced ability to participate in the back-and-forth flow of social interaction appropriate to culture and developmental level, which is normally characterized by an influence of the behavior of one person on the behavior of another person. This results in difficulty interacting with others through emotional, physical, or verbal communication. Evidence: PCS. Frequency: 5/5. (PMID:28837161)
- Aggressive behavior (HP:0000718): Behavior or an act aimed at harming a person, animal, or physical property (e.g., acts of physical violence; shouting, swearing, and using harsh language; slashing someone's tires). Evidence: PCS. Frequency: 5/5. (PMID:28837161)
- Autosomal recessive inheritance (HP:0000007): A mode of inheritance that is observed for traits related to a gene encoded on one of the autosomes (i.e., the human chromosomes 1-22) in which a trait manifests in individuals with two pathogenic alleles, either homozygotes (two copies of the same mutant allele) or compound heterozygotes (whereby each copy of a gene has a distinct mutant allele). Evidence: PCS. (PMID:28837161)
- Spasticity (HP:0001257): A motor disorder characterized by a velocity-dependent increase in tonic stretch reflexes with increased muscle tone, exaggerated (hyperexcitable) tendon reflexes. Evidence: PCS. Frequency: 2/5. (PMID:28837161)